- Coarse facial features (HP:0000280): Absence of fine and sharp appearance of brows, nose, lips, mouth, and chin, usually because of rounded and heavy features or thickened skin with or without thickening of subcutaneous and bony tissues. Evidence: TAS. Frequency: Very frequent (HP:0040281). (ORPHA:363705)
- Hypertrichosis (HP:0000998): Hypertrichosis is increased hair growth that is abnormal in quantity or location. Evidence: TAS. Frequency: Very frequent (HP:0040281). (ORPHA:363705)
- Congenital, generalized hypertrichosis (HP:0004540): A confluent, generalized overgrowth of silvery blonde to gray lanugo hair at birth. Evidence: TAS. Frequency: Very frequent (HP:0040281). (ORPHA:363705)
- Thick hair (HP:0100874): Increased density of hairs, i.e., and elevated number of hairs per unit area. Evidence: TAS. Frequency: Very frequent (HP:0040281). (ORPHA:363705)
- Long philtrum (HP:0000343): Distance between nasal base and midline upper lip vermilion border more than 2 SD above the mean. Alternatively, an apparently increased distance between nasal base and midline upper lip vermilion border. Evidence: TAS. Frequency: Frequent (HP:0040282). (ORPHA:363705)
- Edema (HP:0000969): An abnormal accumulation of fluid beneath the skin, or in one or more cavities of the body. Evidence: TAS. Frequency: Frequent (HP:0040282). (ORPHA:363705)
- Cutis laxa (HP:0000973): Wrinkled, redundant, inelastic and sagging skin. Evidence: TAS. Frequency: Frequent (HP:0040282). (ORPHA:363705)
- Prominent superficial veins (HP:0001015): A condition in which superficial veins (i.e., veins just under the skin) are more conspicuous or noticeable than normal. Evidence: TAS. Frequency: Frequent (HP:0040282). (ORPHA:363705)
- Seizure (HP:0001250): A seizure is an intermittent abnormality of nervous system physiology characterized by a transient occurrence of signs and/or symptoms due to abnormal excessive or synchronous neuronal activity in the brain. Evidence: TAS. Frequency: Frequent (HP:0040282). (ORPHA:363705)
- Hypotonia (HP:0001252): Hypotonia is an abnormally low muscle tone (the amount of tension or resistance to movement in a muscle). Even when relaxed, muscles have a continuous and passive partial contraction which provides some resistance to passive stretching. Hypotonia thus manifests as diminished resistance to passive stretching. Hypotonia is not the same as muscle weakness, although the two conditions can co-exist. Evidence: TAS. Frequency: Frequent (HP:0040282). (ORPHA:363705)
- Global developmental delay (HP:0001263): A delay in the achievement of motor or mental milestones in the domains of development of a child, including motor skills, speech and language, cognitive skills, and social and emotional skills. This term should only be used to describe children younger than five years of age. Evidence: TAS. Frequency: Frequent (HP:0040282). (ORPHA:363705)
- Joint hypermobility (HP:0001382): The capability that a joint (or a group of joints) has to move, passively and/or actively, beyond normal limits along physiological axes. Evidence: TAS. Frequency: Frequent (HP:0040282). (ORPHA:363705)
- Polyhydramnios (HP:0001561): The presence of excess amniotic fluid in the uterus during pregnancy. Evidence: TAS. Frequency: Frequent (HP:0040282). (ORPHA:363705)
- Premature birth (HP:0001622): The birth of a baby of less than 37 weeks of gestational age. Evidence: TAS. Frequency: Frequent (HP:0040282). (ORPHA:363705)
- Cardiomegaly (HP:0001640): Increased size of the heart, clinically defined as an increased transverse diameter of the cardiac silhouette that is greater than or equal to 50% of the transverse diameter of the chest (increased cardiothoracic ratio) on a posterior-anterior projection of a chest radiograph or a computed tomography. Evidence: TAS. Frequency: Frequent (HP:0040282). (ORPHA:363705)
- Patent ductus arteriosus (HP:0001643): In utero, the ductus arteriosus (DA) serves to divert ventricular output away from the lungs and toward the placenta by connecting the main pulmonary artery to the descending aorta. A patent ductus arteriosus (PDA) in the first 3 days of life is a physiologic shunt in healthy term and preterm newborn infants, and normally is substantially closed within about 24 hours after bith and completely closed after about three weeks. Failure of physiologcal closure is referred to a persistent or patent ductus arteriosus (PDA). Depending on the degree of left-to-right shunting, PDA can have clinical consequences. Evidence: TAS. Frequency: Frequent (HP:0040282). (ORPHA:363705)
- Pericardial effusion (HP:0001698): Accumulation of fluid within the pericardium. Evidence: TAS. Frequency: Frequent (HP:0040282). (ORPHA:363705)
- Gastroesophageal reflux (HP:0002020): A condition in which the stomach contents leak backwards from the stomach into the esophagus through the lower esophageal sphincter. Evidence: TAS. Frequency: Frequent (HP:0040282). (ORPHA:363705)
- Migraine (HP:0002076): Migraine is a chronic neurological disorder characterized by episodic attacks of headache and associated symptoms. Evidence: TAS. Frequency: Frequent (HP:0040282). (ORPHA:363705)
- Dyspnea (HP:0002094): Difficult or labored breathing. Dyspnea is a subjective feeling only the patient can rate, e.g., on a Borg scale. Evidence: TAS. Frequency: Frequent (HP:0040282). (ORPHA:363705)
- Respiratory distress (HP:0002098): Respiratory distress is objectively observable as the physical or emotional consequences from the experience of dyspnea. The physical presentation of respiratory distress is generally referred to as labored breathing, while the sensation of respiratory distress is called shortness of breath or dyspnea. Evidence: TAS. Frequency: Frequent (HP:0040282). (ORPHA:363705)
- Headache (HP:0002315): Cephalgia, or pain sensed in various parts of the head, not confined to the area of distribution of any nerve. Evidence: TAS. Frequency: Frequent (HP:0040282). (ORPHA:363705)
- Exercise intolerance (HP:0003546): A functional motor deficit where individuals whose responses to the challenges of exercise fail to achieve levels considered normal for their age and gender. Evidence: TAS. Frequency: Frequent (HP:0040282). (ORPHA:363705)
- Depressed nasal bridge (HP:0005280): Posterior positioning of the nasal root in relation to the overall facial profile for age. Evidence: TAS. Frequency: Frequent (HP:0040282). (ORPHA:363705)
- Palmoplantar cutis laxa (HP:0007517): Loose, wrinkled skin of hands and feet. Evidence: TAS. Frequency: Frequent (HP:0040282). (ORPHA:363705)
- Hyperintensity of cerebral white matter on MRI (HP:0030890): A brighter than expected signal on magnetic resonance imaging emanating from the cerebral white matter. Evidence: TAS. Frequency: Frequent (HP:0040282). (ORPHA:363705)
- Premature skin wrinkling (HP:0100678): The presence of an increased degree of wrinkling (irregular folds and indentations) of the skin as compared with age-related norms. Evidence: TAS. Frequency: Frequent (HP:0040282). (ORPHA:363705)
- Macroglossia (HP:0000158): Increased length and width of the tongue. Evidence: TAS. Frequency: Occasional (HP:0040283). (ORPHA:363705)
- Epicanthus (HP:0000286): A fold of skin starting above the medial aspect of the upper eyelid and arching downward to cover, pass in front of and lateral to the medial canthus. Evidence: TAS. Frequency: Occasional (HP:0040283). (ORPHA:363705)
- Low anterior hairline (HP:0000294): Distance between the hairline (trichion) and the glabella (the most prominent point on the frontal bone above the root of the nose), in the midline, more than two SD below the mean. Alternatively, an apparently decreased distance between the hairline and the glabella. Evidence: TAS. Frequency: Occasional (HP:0040283). (ORPHA:363705)
- Hypertelorism (HP:0000316): Interpupillary distance more than 2 SD above the mean (alternatively, the appearance of an increased interpupillary distance or widely spaced eyes). Evidence: TAS. Frequency: Occasional (HP:0040283). (ORPHA:363705)
- Proptosis (HP:0000520): An eye that is protruding anterior to the plane of the face to a greater extent than is typical. Evidence: TAS. Frequency: Occasional (HP:0040283). (ORPHA:363705)
- Pectus carinatum (HP:0000768): A deformity of the chest caused by overgrowth of the ribs and characterized by protrusion of the sternum. Evidence: TAS. Frequency: Occasional (HP:0040283). (ORPHA:363705)
- Hemiparesis (HP:0001269): Loss of strength in the arm, leg, and sometimes face on one side of the body. Hemiplegia refers to a complete loss of strength, whereas hemiparesis refers to an incomplete loss of strength. Evidence: TAS. Frequency: Occasional (HP:0040283). (ORPHA:363705)
- Stroke (HP:0001297): Sudden impairment of blood flow to a part of the brain due to occlusion or rupture of an artery to the brain. Evidence: TAS. Frequency: Occasional (HP:0040283). (ORPHA:363705)
- Specific learning disability (HP:0001328): Impairment of certain skills such as reading or writing, coordination, self-control, or attention that interfere with the ability to learn. The impairment is not related to a global deficiency of intelligence. Evidence: TAS. Frequency: Occasional (HP:0040283). (ORPHA:363705)
- Large for gestational age (HP:0001520): The term large for gestational age applies to babies whose birth weight lies above the 90th percentile for that gestational age. Evidence: TAS. Frequency: Occasional (HP:0040283). (ORPHA:363705)
- Congestive heart failure (HP:0001635): The presence of an abnormality of cardiac function that is responsible for the failure of the heart to pump blood at a rate that is commensurate with the needs of the tissues or a state in which abnormally elevated filling pressures are required for the heart to do so. Heart failure is frequently related to a defect in myocardial contraction. Evidence: TAS. Frequency: Occasional (HP:0040283). (ORPHA:363705)
- Aortic valve stenosis (HP:0001650): The presence of a stenosis (narrowing) of the aortic valve. Evidence: TAS. Frequency: Occasional (HP:0040283). (ORPHA:363705)
- Mitral regurgitation (HP:0001653): An abnormality of the mitral valve characterized by insufficiency or incompetence of the mitral valve resulting in retrograde leaking of blood through the mitral valve upon ventricular contraction. Evidence: TAS. Frequency: Occasional (HP:0040283). (ORPHA:363705)
- Abnormal heart valve morphology (HP:0001654): Any structural abnormality of a cardiac valve. Evidence: TAS. Frequency: Occasional (HP:0040283). (ORPHA:363705)
- Pulmonary arterial hypertension (HP:0002092): Pulmonary hypertension is defined mean pulmonary artery pressure of 25mmHg or more and pulmonary capillary wedge pressure of 15mmHg or less when measured by right heart catheterisation at rest and in a supine position. Evidence: TAS. Frequency: Occasional (HP:0040283). (ORPHA:363705)
- Gastrointestinal hemorrhage (HP:0002239): Hemorrhage affecting the gastrointestinal tract. Evidence: TAS. Frequency: Occasional (HP:0040283). (ORPHA:363705)
- Gastrointestinal dysmotility (HP:0002579): Abnormal intestinal contractions, such as spasms and intestinal paralysis, related to the loss of the ability of the gut to coordinate muscular activity because of endogenous or exogenous causes. Evidence: TAS. Frequency: Occasional (HP:0040283). (ORPHA:363705)
- Scoliosis (HP:0002650): The presence of an abnormal lateral curvature of the spine. Evidence: TAS. Frequency: Occasional (HP:0040283). (ORPHA:363705)
- Skeletal dysplasia (HP:0002652): A general term describing features characterized by abnormal development of bones and connective tissues. Evidence: TAS. Frequency: Occasional (HP:0040283). (ORPHA:363705)
- Prominent median palatal raphe (HP:0002708): Unusual prominence of the median palatal raphe, which is the ridge formed by the fusion of the two plates of the skull that form the hard palate. Evidence: TAS. Frequency: Occasional (HP:0040283). (ORPHA:363705)
- Short stature (HP:0004322): A height below that which is expected according to age and gender norms. Although there is no universally accepted definition of short stature, many refer to "short stature" as height more than 2 standard deviations below the mean for age and gender (or below the 3rd percentile for age and gender dependent norms). Evidence: TAS. Frequency: Occasional (HP:0040283). (ORPHA:363705)
- Sacral hypertrichosis (HP:0004532): Excessive, increased hair growth located in the sacral region. Evidence: TAS. Frequency: Occasional (HP:0040283). (ORPHA:363705)
- Dilatation of the cerebral artery (HP:0004944): The presence of a localized dilatation or ballooning of a cerebral artery. Evidence: TAS. Frequency: Occasional (HP:0040283). (ORPHA:363705)
- Anomalous branches of internal carotid artery (HP:0005314). Evidence: TAS. Frequency: Occasional (HP:0040283). (ORPHA:363705)
- Finger joint hypermobility (HP:0006094). Evidence: TAS. Frequency: Occasional (HP:0040283). (ORPHA:363705)
- Prominent forehead (HP:0011220): Forward prominence of the entire forehead, due to protrusion of the frontal bone. Evidence: TAS. Frequency: Occasional (HP:0040283). (ORPHA:363705)
- Arrhythmia (HP:0011675): Any cardiac rhythm other than the normal sinus rhythm. Such a rhythm may be either of sinus or ectopic origin and either regular or irregular. An arrhythmia may be due to a disturbance in impulse formation or conduction or both. Evidence: TAS. Frequency: Occasional (HP:0040283). (ORPHA:363705)
- Persistent fetal circulation (HP:0011726): Systemic desaturation of a liveborn baby resulting from persistent pulmonary hypertension with a patent ductus arteriosus and patent foramen ovale, such that the circulation in postnatal life follows the fetal course. Evidence: TAS. Frequency: Occasional (HP:0040283). (ORPHA:363705)
- Thick vermilion border (HP:0012471): Increased width of the skin of vermilion border region of upper lip. Evidence: TAS. Frequency: Occasional (HP:0040283). (ORPHA:363705)
- Lower eyelid edema (HP:0012568): Edema in the region of the Lower eyelid. Evidence: TAS. Frequency: Occasional (HP:0040283). (ORPHA:363705)
- Abnormal cerebral vascular morphology (HP:0100659): An anomaly of the cerebral blood vessels. Evidence: TAS. Frequency: Occasional (HP:0040283). (ORPHA:363705)
- Hernia (HP:0100790). Evidence: TAS. Frequency: Occasional (HP:0040283). (ORPHA:363705)
- Gingival overgrowth (HP:0000212): Hyperplasia of the gingiva (that is, a thickening of the soft tissue overlying the alveolar ridge. The degree of thickening ranges from involvement of the interdental papillae alone to gingival overgrowth covering the entire tooth crown. Evidence: TAS. Frequency: Very rare (HP:0040284). (ORPHA:363705)
- Osteopenia (HP:0000938): Osteopenia is a term to define bone density that is not normal but also not as low as osteoporosis. By definition from the World Health Organization osteopenia is defined by bone densitometry as a T score -1 to -2.5. Evidence: TAS. Frequency: Very rare (HP:0040284). (ORPHA:363705)
- Osteoporosis (HP:0000939): Osteoporosis is a systemic skeletal disease characterized by low bone density and microarchitectural deterioration of bone tissue with a consequent increase in bone fragility. According to the WHO criteria, osteoporosis is defined as a BMD that lies 2.5 standard deviations or more below the average value for young healthy adults (a T-score below -2.5 SD). Evidence: TAS. Frequency: Very rare (HP:0040284). (ORPHA:363705)
- Large hands (HP:0001176). Evidence: TAS. Frequency: Very rare (HP:0040284). (ORPHA:363705)
- Mild intellectual disability (HP:0001256): Mild intellectual disability (ID) is defined as a type of ID characterized by mildly sub-average adaptive functioning and intellectual functioning, with an intelligence quotient (IQ) the range of 50-69. Evidence: TAS. Frequency: Very rare (HP:0040284). (ORPHA:363705)
- Ventricular septal defect (HP:0001629): A hole between the two bottom chambers (ventricles) of the heart. The defect is centered around the most superior aspect of the ventricular septum. Evidence: TAS. Frequency: Very rare (HP:0040284). (ORPHA:363705)
- Atrial septal defect (HP:0001631): Atrial septal defect (ASD) is a congenital abnormality of the interatrial septum that enables blood flow between the left and right atria via the interatrial septum. Evidence: TAS. Frequency: Very rare (HP:0040284). (ORPHA:363705)
- Bicuspid aortic valve (HP:0001647): The presence of an aortic valve with two instead of the normal three cusps (flaps). Bicuspid aortic valvue is a malformation of a commissure (small space between the attachment of each cusp to the aortic wall) and the adjacent parts of the two corresponding cusps forming a raphe (the fused area of the two underdeveloped cusps turning into a malformed commissure between both cusps; the raphe is a fibrous ridge that extends from the commissure to the free edge of the two underdeveloped, conjoint cusps). Evidence: TAS. Frequency: Very rare (HP:0040284). (ORPHA:363705)
- Coarctation of aorta (HP:0001680): Coarctation of the aorta is a narrowing or constriction of a segment of the aorta. Evidence: TAS. Frequency: Very rare (HP:0040284). (ORPHA:363705)
- Pyloric stenosis (HP:0002021): Pyloric stenosis, also known as infantile hypertrophic pyloric stenosis, is an uncommon condition in infants characterized by abnormal thickening of the pylorus muscles in the stomach leading to gastric outlet obstruction. Clinically infants are well at birth. Then, at 3 to 6 weeks of age, the infants present with projectile vomiting, potentially leading to dehydration and weight loss. Evidence: TAS. Frequency: Very rare (HP:0040284). (ORPHA:363705)
These phenotypes are associated with the disease Craniofaciofrontodigital syndrome (ORPHA:363705).